Phenotypes associated with the disease trichilemmal cyst (OMIM:609649):
- Autosomal dominant inheritance (HP:0000006): A mode of inheritance that is observed for traits related to a gene encoded on one of the autosomes (i.e., the human chromosomes 1-22) in which a trait manifests in heterozygotes. In the context of medical genetics, an autosomal dominant disorder is caused when a single copy of the mutant allele is present. Males and females are affected equally, and can both transmit the disorder with a risk of 50% for each child of inheriting the mutant allele. Evidence: IEA. (OMIM:609649)
- Abnormality of the skin (HP:0000951): An abnormality of the skin. Evidence: IEA. (OMIM:609649)